- Scoliosis (HP:0002650): The presence of an abnormal lateral curvature of the spine. Evidence: PCS. Frequency: Occasional (HP:0040283). (PMID:21636067)
- Congenital, generalized hypertrichosis (HP:0004540): A confluent, generalized overgrowth of silvery blonde to gray lanugo hair at birth. Evidence: PCS. (PMID:21636067)
- X-linked dominant inheritance (HP:0001423): A mode of inheritance that is observed for dominant traits related to a gene encoded on the X chromosome. In the context of medical genetics, X-linked dominant disorders tend to manifest very severely in affected males. The severity of manifestation in females may depend on the degree of skewed X inactivation. Evidence: PCS. (PMID:21636067)
- Hirsutism (HP:0001007): Abnormally increased hair growth referring to a male pattern of body hair (androgenic hair). Evidence: PCS. (PMID:21636067)
These phenotypes are associated with the disease X-linked congenital generalized hypertrichosis (OMIM:307150).